- Bruxism (HP:0003763): Bruxism is characterized by the grinding of the teeth including the clenching of the jaw and typically occur during sleep. Evidence: TAS. (OMIM:606840)
- Myoclonus (HP:0001336): Very brief, involuntary random muscular contractions occurring at rest, in response to sensory stimuli, or accompanying voluntary movements. Evidence: TAS. (OMIM:606840)
These phenotypes are associated with the disease parasomnia, sleep bruxism type (OMIM:606840).